Phenotypes associated with the disease Infantile hypotonia-oculomotor anomalies-hyperkinetic movements-developmental delay syndrome (ORPHA:522077):
- Dermoid cyst (HP:0025247): A congenital subcutaneous cyst that arises from entrapment of skin along the lines of embryonic fusion. In contrast to epidermal cysts, dermoid cysts tend to contain various adnexal structures such as hair, sebaceous, eccrine or apocrine glands. Dermoid cysts are present at birth, and are indolent, firm, deep, subcutaneous nodules. They are often located on the head and neck, and rarely in the anogenital area. Dermoid cysts are slowly progressive and can grow to a size of 1 to 4 cm. Evidence: TAS. Frequency: Occasional (HP:0040283). (ORPHA:522077)
- Abnormal location of the eyebrow (HP:0040296): Anomalous anatomical placement of the eyebrow. Evidence: TAS. Frequency: Occasional (HP:0040283). (ORPHA:522077)
- Hemiballismus (HP:0100248): Hemiballismus is a rare movement disorder that is caused primarily by damage to various areas in the basal ganglia. Hemiballismus is usually characterized by involuntary flinging motions of the extremities. The movements are often violent and have wide amplitudes of motion. They are continuous and random and can involve proximal and/or distal muscles on one side of the body, while some cases even include the facial muscles. The more a patient is active, the more the movements increase. With relaxation comes a decrease in movements. Evidence: TAS. Frequency: Occasional (HP:0040283). (ORPHA:522077)
- Autistic behavior (HP:0000729): Persistent deficits in social interaction and communication and interaction as well as a markedly restricted repertoire of activity and interest as well as repetitive patterns of behavior. Evidence: TAS. Frequency: Very frequent (HP:0040281). (ORPHA:522077)
- Motor delay (HP:0001270): A type of Developmental delay characterized by a delay in acquiring motor skills. Evidence: TAS. Frequency: Very frequent (HP:0040281). (ORPHA:522077)
- Absent speech (HP:0001344): Complete lack of development of speech and language abilities. Evidence: TAS. Frequency: Very frequent (HP:0040281). (ORPHA:522077)
- EEG abnormality (HP:0002353): Abnormality observed by electroencephalogram (EEG), which is used to record of the brain's spontaneous electrical activity from multiple electrodes placed on the scalp. Evidence: TAS. Frequency: Very frequent (HP:0040281). (ORPHA:522077)
- Floppy infant (HP:0008947): Floppiness/hypotonia is defined as reduced resistance to passive movement of joints. Physical examination of floppy/hypotonic infants shows head lag, lack of shoulder and elbow muscle contraction on traction response, inability to tighten the shoulder girdle muscles (or slipping through) when held under the axillae, scarf sign (when the arm is pulled to the opposite side, the arm wraps around the neck with the elbow crossing midline), hyperdorsiflexion of the feet, easy apposition of the thumb against the forearm, feet touching the cheek with ease and without discomfort, frog leg position, and inverted U sign on ventral suspension (head, arms, and legs hanging down without elbow or knee flexion and the trunk rounded in a dome shape). Evidence: TAS. Frequency: Very frequent (HP:0040281). (ORPHA:522077)
- Severe global developmental delay (HP:0011344): A severe delay in the achievement of motor or mental milestones in the domains of development of a child. Evidence: TAS. Frequency: Very frequent (HP:0040281). (ORPHA:522077)
- Strabismus (HP:0000486): A misalignment of the eyes so that the visual axes deviate from bifoveal fixation. The classification of strabismus may be based on a number of features including the relative position of the eyes, whether the deviation is latent or manifest, intermittent or constant, concomitant or otherwise and according to the age of onset and the relevance of any associated refractive error. Evidence: TAS. Frequency: Frequent (HP:0040282). (ORPHA:522077)
- Esotropia (HP:0000565): A form of strabismus with one or both eyes turned inward ('crossed') to a relatively severe degree, usually defined as 10 diopters or more. Evidence: TAS. Frequency: Frequent (HP:0040282). (ORPHA:522077)
- Nystagmus (HP:0000639): Rhythmic, involuntary oscillations of one or both eyes related to abnormality in fixation, conjugate gaze, or vestibular mechanisms. Evidence: TAS. Frequency: Frequent (HP:0040282). (ORPHA:522077)
- Motor stereotypy (HP:0000733): Use of the same abnormal action in response to certain triggers or at random. They may be used as a way to regulate one's internal state but must otherwise have no apparent functional purpose. Evidence: TAS. Frequency: Frequent (HP:0040282). (ORPHA:522077)
- Reduced eye contact (HP:0000817): A reduced frequency or duration of eye contact. Evidence: TAS. Frequency: Frequent (HP:0040282). (ORPHA:522077)
- Intellectual disability (HP:0001249): The term intellectual disability or intellectual developmental disorder is used to describe significantly sub-average intellectual and adaptive functioning based on clinical assessment and as measured by individually administered, appropriately normed, standardized and validated tests of intellectual functioning and adaptive behavior, with onset during the developmental period from infancy through adolescence. Evidence: TAS. Frequency: Frequent (HP:0040282). (ORPHA:522077)
- Vomiting (HP:0002013): Forceful ejection of the contents of the stomach through the mouth by means of a series of involuntary spasmic contractions. Evidence: TAS. Frequency: Frequent (HP:0040282). (ORPHA:522077)
- Gastroesophageal reflux (HP:0002020): A condition in which the stomach contents leak backwards from the stomach into the esophagus through the lower esophageal sphincter. Evidence: TAS. Frequency: Frequent (HP:0040282). (ORPHA:522077)
- Sleep disturbance (HP:0002360): An abnormal pattern in the quality, quantity, or characteristics of sleep. Evidence: TAS. Frequency: Frequent (HP:0040282). (ORPHA:522077)
- Hyperkinetic movements (HP:0002487): Motor hyperactivity with excessive movement of muscles of the body as a whole. Evidence: TAS. Frequency: Frequent (HP:0040282). (ORPHA:522077)
- Repetitive compulsive behavior (HP:0008762). Evidence: TAS. Frequency: Frequent (HP:0040282). (ORPHA:522077)
- Poor visual behavior for age (HP:0025152): Lack of visual responsiveness or decrease in visual capabilities suggesting a lack of visual responsiveness or decrease in visual capabilities in an infant or young child in which visual behavior fails to meet normal developmental milestones. Evidence: TAS. Frequency: Frequent (HP:0040282). (ORPHA:522077)
- Thin upper lip vermilion (HP:0000219): Height of the vermilion of the upper lip in the midline more than 2 SD below the mean. Alternatively, an apparently reduced height of the vermilion of the upper lip in the frontal view (subjective). Evidence: TAS. Frequency: Occasional (HP:0040283). (ORPHA:522077)
- Brachyturricephaly (HP:0000244): Abnormal vertical height of the skull and a shortening of its anterior-posterior length, frequently combined with malformations of the occipital region. Evidence: TAS. Frequency: Occasional (HP:0040283). (ORPHA:522077)
- Epicanthus (HP:0000286): A fold of skin starting above the medial aspect of the upper eyelid and arching downward to cover, pass in front of and lateral to the medial canthus. Evidence: TAS. Frequency: Occasional (HP:0040283). (ORPHA:522077)
- Smooth philtrum (HP:0000319): Flat skin surface, with no ridge formation in the central region of the upper lip between the nasal base and upper vermilion border. Evidence: TAS. Frequency: Occasional (HP:0040283). (ORPHA:522077)
- Widow's peak (HP:0000349): Frontal hairline with bilateral arcs to a low point in the midline of the forehead. Evidence: TAS. Frequency: Occasional (HP:0040283). (ORPHA:522077)
- Hypermetropia (HP:0000540): An abnormality of refraction characterized by the ability to see objects in the distance clearly, while objects nearby appear blurry. Evidence: TAS. Frequency: Occasional (HP:0040283). (ORPHA:522077)
- Agitation (HP:0000713): A state of excessive motor activity that is associated with mental distress or a feeling of substantial unease or inner tension. Distinguished from restlessness by the increased level of emotional distress and negative intensity of the experience. Agitation has a significant level of physical activity that is typically threatening to the self or others. Evidence: TAS. Frequency: Occasional (HP:0040283). (ORPHA:522077)
- Anxiety (HP:0000739): Intense feelings of nervousness, tension, or panic often arise in response to interpersonal stresses. There is worry about the negative effects of past unpleasant experiences and future negative possibilities. Individuals may feel fearful, apprehensive, or threatened by uncertainty, and they may also have fears of falling apart or losing control. Evidence: TAS. Frequency: Occasional (HP:0040283). (ORPHA:522077)
- Self-mutilation (HP:0000742): Deliberate harm to one's body resulting in tissue damage, without a conscious intent to die. Evidence: TAS. Frequency: Occasional (HP:0040283). (ORPHA:522077)
- Ataxia (HP:0001251): Ataxia refers to impaired coordination of voluntary muscle movement. Cerebellar ataxia refers to ataxia due to dysfunction of the cerebellum. This causes a variety of elementary neurological deficits including asynergy (lack of coordination between muscles, limbs and joints), dysmetria (lack of ability to judge distances that can lead to under- or overshoot in grasping movements), and dysdiadochokinesia (inability to perform rapid movements requiring antagonizing muscle groups to be switched on and off repeatedly). Evidence: TAS. Frequency: Occasional (HP:0040283). (ORPHA:522077)
- Choreoathetosis (HP:0001266): Involuntary movements characterized by both athetosis (inability to sustain muscles in a fixed position) and chorea (widespread jerky arrhythmic movements). Evidence: TAS. Frequency: Occasional (HP:0040283). (ORPHA:522077)
- Dystonia (HP:0001332): An abnormally increased muscular tone that causes fixed abnormal postures. There is a slow, intermittent twisting motion that leads to exaggerated turning and posture of the extremities and trunk. Evidence: TAS. Frequency: Occasional (HP:0040283). (ORPHA:522077)
- Joint hypermobility (HP:0001382): The capability that a joint (or a group of joints) has to move, passively and/or actively, beyond normal limits along physiological axes. Evidence: TAS. Frequency: Occasional (HP:0040283). (ORPHA:522077)
- Laryngomalacia (HP:0001601): Laryngomalacia is a congenital abnormality of the laryngeal cartilage in which the cartilage is floppy and prolapses over the larynx during inspiration. Evidence: TAS. Frequency: Occasional (HP:0040283). (ORPHA:522077)
- Atrial septal defect (HP:0001631): Atrial septal defect (ASD) is a congenital abnormality of the interatrial septum that enables blood flow between the left and right atria via the interatrial septum. Evidence: TAS. Frequency: Occasional (HP:0040283). (ORPHA:522077)
- Bilateral talipes equinovarus (HP:0001776): Bilateral clubfoot deformity. Evidence: TAS. Frequency: Occasional (HP:0040283). (ORPHA:522077)
- Chorea (HP:0002072): Chorea (Greek for 'dance') refers to widespread arrhythmic involuntary movements of a forcible, jerky and restless fashion. It is a random-appearing sequence of one or more discrete involuntary movements or movement fragments. Movements appear random because of variability in timing, duration or location. Each movement may have a distinct start and end. However, movements may be strung together and thus may appear to flow randomly from one muscle group to another. Chorea can involve the trunk, neck, face, tongue, and extremities. Evidence: TAS. Frequency: Occasional (HP:0040283). (ORPHA:522077)
- Poor speech (HP:0002465). Evidence: TAS. Frequency: Occasional (HP:0040283). (ORPHA:522077)
- Scoliosis (HP:0002650): The presence of an abnormal lateral curvature of the spine. Evidence: TAS. Frequency: Occasional (HP:0040283). (ORPHA:522077)
- Central apnea (HP:0002871): Apnea resulting from depression of the respiratory centers in the medulla oblongata. There is a lack of respiratory effort rather than obstruction of airflow. Evidence: TAS. Frequency: Occasional (HP:0040283). (ORPHA:522077)
- Hyperventilation (HP:0002883): Hyperventilation refers to an increased pulmonary ventilation rate that is faster than necessary for the exchange of gases. Hyperventilation can result from increased frequency of breathing, an increased tidal volume, or both, and leads to an excess intake of oxygen and the blowing off of carbon dioxide. Evidence: TAS. Frequency: Occasional (HP:0040283). (ORPHA:522077)
- Lumbar hyperlordosis (HP:0002938): An abnormal accentuation of the inward curvature of the spine in the lumbar region. Evidence: TAS. Frequency: Occasional (HP:0040283). (ORPHA:522077)
- Short nose (HP:0003196): Distance from nasion to subnasale more than two standard deviations below the mean, or alternatively, an apparently decreased length from the nasal root to the nasal tip. Evidence: TAS. Frequency: Occasional (HP:0040283). (ORPHA:522077)
- 2-3 toe syndactyly (HP:0004691): Syndactyly with fusion of toes two and three. Evidence: TAS. Frequency: Occasional (HP:0040283). (ORPHA:522077)
- Intermittent hyperventilation (HP:0004879): Episodic hyperventilation. Evidence: TAS. Frequency: Occasional (HP:0040283). (ORPHA:522077)
- Prominent nasal tip (HP:0005274). Evidence: TAS. Frequency: Occasional (HP:0040283). (ORPHA:522077)
- Progressive flexion contractures (HP:0005876): Progressively worsening joint contractures. Evidence: TAS. Frequency: Occasional (HP:0040283). (ORPHA:522077)
- Almond-shaped palpebral fissure (HP:0007874): A shape created by an acute downward arching of the upper eyelid and upward arching of the lower eyelid, toward the medial canthus, which gives the outline of the palpebral fissures the configuration of an almond. Thus, the maximum distance between the fissures is offset from, and medial to, the center point. Evidence: TAS. Frequency: Occasional (HP:0040283). (ORPHA:522077)
- Pes valgus (HP:0008081): An outward (valgus) deviation of the calcaneus relative to the longitudinal axis of the lower leg at the talocalcaneal (subtalar) joint, such that the heel is everted. Evidence: TAS. Frequency: Occasional (HP:0040283). (ORPHA:522077)
- Equinus calcaneus (HP:0008138): Abnormal plantar flexion of the calcaneus relative to the longitudinal axis of the tibia. This results in the angle between the long axis of the tibia and the long axis of the heel bone (calcaneus) being greater than 90 degrees. Evidence: TAS. Frequency: Occasional (HP:0040283). (ORPHA:522077)
- Sleep apnea (HP:0010535): An intermittent cessation of airflow at the mouth and nose during sleep is known as sleep apnea. Apneas that last at least 10 seconds are considered significant, but individuals with sleep apnea may experience apneas lasting from 20 seconds up to 2 or 3 minutes. Patients may have up to 15 events per hour of sleep. Evidence: TAS. Frequency: Occasional (HP:0040283). (ORPHA:522077)
- EEG with spike-wave complexes (HP:0010850): Complexes of spikes (<70 ms) and sharp waves (70-200 ms), which are sharp transient waves that have a strong association with epilepsy, in cerebral electrical activity recorded along the scalp by electroencephalography (EEG). Evidence: TAS. Frequency: Occasional (HP:0040283). (ORPHA:522077)
- EEG with series of focal spikes (HP:0011194): Focal spikes occurring for several seconds. Evidence: TAS. Frequency: Occasional (HP:0040283). (ORPHA:522077)
- EEG with focal sharp waves (HP:0011196): EEG with focal sharp transient waves of a duration between 80 and 200 msec. Evidence: TAS. Frequency: Occasional (HP:0040283). (ORPHA:522077)
- Horizontal eyebrow (HP:0011228): An eyebrow that extends straight across the brow, without curve. Evidence: TAS. Frequency: Occasional (HP:0040283). (ORPHA:522077)
- Athetoid cerebral palsy (HP:0011445): A type of cerebral palsy characterized by slow, involuntary muscle movement and mixed muscle tone. Evidence: TAS. Frequency: Occasional (HP:0040283). (ORPHA:522077)
- Feeding difficulties (HP:0011968): Impaired ability to eat related to problems gathering food and getting ready to suck, chew, or swallow it. Evidence: TAS. Frequency: Occasional (HP:0040283). (ORPHA:522077)
- Self-biting (HP:0012169): Habitual biting of one's own body. Evidence: TAS. Frequency: Occasional (HP:0040283). (ORPHA:522077)
- Delayed myelination (HP:0012448): Delayed myelination. Evidence: TAS. Frequency: Occasional (HP:0040283). (ORPHA:522077)